- Intrauterine growth retardation (HP:0001511): An abnormal restriction of fetal growth with fetal weight below the tenth percentile for gestational age. Evidence: TAS. Frequency: Very frequent (HP:0040281). (ORPHA:436144)
- Short stature (HP:0004322): A height below that which is expected according to age and gender norms. Although there is no universally accepted definition of short stature, many refer to "short stature" as height more than 2 standard deviations below the mean for age and gender (or below the 3rd percentile for age and gender dependent norms). Evidence: TAS. Frequency: Very frequent (HP:0040281). (ORPHA:436144)
- Decreased testicular size (HP:0008734): Reduced volume of the testicle (the male gonad). Evidence: TAS. Frequency: Very frequent (HP:0040281). (ORPHA:436144)
These phenotypes are associated with the disease Intrauterine growth restriction-short stature-early adult-onset diabetes syndrome (ORPHA:436144).